Phenotypes associated with the disease autosomal recessive nonsyndromic hearing loss 89 (OMIM:613916):
- Sensorineural hearing impairment (HP:0000407): A type of hearing impairment in one or both ears related to an abnormal functionality of the cochlear nerve. Evidence: PCS. Frequency: 13/13. (PMID:23768514)
- Infantile onset (HP:0003593): Onset of signs or symptoms of disease between 28 days to one year of life. Evidence: PCS. Frequency: 13/13. (PMID:23768514)
- Autosomal recessive inheritance (HP:0000007): A mode of inheritance that is observed for traits related to a gene encoded on one of the autosomes (i.e., the human chromosomes 1-22) in which a trait manifests in individuals with two pathogenic alleles, either homozygotes (two copies of the same mutant allele) or compound heterozygotes (whereby each copy of a gene has a distinct mutant allele). Evidence: PCS. (PMID:23768514)
- Vestibular hyporeflexia (HP:0001756): A general descriptive term that describes impaired functioning of the vestibular apparatus that leads to manifestations such as dizziness or postural imbalance. Evidence: PCS. Frequency: 0/13. (PMID:23768514)